- Neoplasm (HP:0002664): An organ or organ-system abnormality that consists of uncontrolled autonomous cell-proliferation which can occur in any part of the body as a benign or malignant neoplasm (tumor). Evidence: PCS. (PMID:10471491)
- Typified by somatic mosaicism (HP:0001442): Description of conditions in which affected individuals typically display somatic mosaicism, i.e., genetically distinct populations of somatic cells in a given organism caused by DNA mutations, epigenetic alterations of DNA, chromosomal abnormalities or the spontaneous reversion of inherited mutations. In many conditions typified by somatic mosaicism, constitutive mutation is lethal and cases are exclusively or predominantly mosaic. Evidence: PCS. (PMID:10471491)
- Cervix cancer (HP:0030079): A tumor of the uterine cervix. Evidence: PCS. (PMID:10471491)
These phenotypes are associated with the disease cervical cancer (OMIM:603956).